- Infantile onset (HP:0003593): Onset of signs or symptoms of disease between 28 days to one year of life. Evidence: IEA. (OMIM:609823)
- Autosomal recessive inheritance (HP:0000007): A mode of inheritance that is observed for traits related to a gene encoded on one of the autosomes (i.e., the human chromosomes 1-22) in which a trait manifests in individuals with two pathogenic alleles, either homozygotes (two copies of the same mutant allele) or compound heterozygotes (whereby each copy of a gene has a distinct mutant allele). Evidence: IEA. (OMIM:609823)
- Severe sensorineural hearing impairment (HP:0008625): A severe form of sensorineural hearing impairment. Evidence: TAS. (OMIM:609823)
These phenotypes are associated with the disease autosomal recessive nonsyndromic hearing loss 28 (OMIM:609823).